- Hyperhidrosis (HP:0000975): Abnormal excessive perspiration (sweating) despite the lack of appropriate stimuli like hot and humid weather. Evidence: TAS. Frequency: Frequent (HP:0040282). (ORPHA:86919)
- Clinodactyly of the 5th finger (HP:0004209): Clinodactyly refers to a bending or curvature of the fifth finger in the radial direction (i.e., towards the 4th finger). Evidence: TAS. Frequency: Very frequent (HP:0040281). (ORPHA:86919)
- Diffuse palmoplantar hyperkeratosis (HP:0007447): Diffuse abnormal thickening of the skin on the palms and soles. Evidence: TAS. Frequency: Very frequent (HP:0040281). (ORPHA:86919)
These phenotypes are associated with the disease Keratosis palmaris et plantaris-clinodactyly syndrome (ORPHA:86919).